- Craniosynostosis (HP:0001363): Craniosynostosis refers to the premature closure of the cranial sutures. Primary craniosynostosis refers to the closure of one or more sutures due to abnormalities in skull development, and secondary craniosynostosis results from failure of brain growth. Evidence: PCS. Frequency: Occasional (HP:0040283). (OMIM:176700)
- Typified by incomplete penetrance (HP:0003829): Description of conditions in which not all individuals with a given genotype exhibit the disease. Penetrance is the proportion that develop disease given a lifespan of 80 years. Evidence: TAS. (OMIM:176700)
- Ectropion of lower eyelids (HP:0007651). Evidence: IEA. (OMIM:176700)
- Thick lower lip vermilion (HP:0000179): Increased thickness of the lower lip, leading to a prominent appearance of the lower lip. The height of the vermilion of the lower lip in the midline is more than 2 SD above the mean. Alternatively, an apparently increased height of the vermilion of the lower lip in the frontal view (subjective). Evidence: TAS. (OMIM:176700)
- Mandibular prognathia (HP:0000303): Abnormal prominence of the chin related to increased length of the mandible. Evidence: IEA. (OMIM:176700)
- Autosomal dominant inheritance (HP:0000006): A mode of inheritance that is observed for traits related to a gene encoded on one of the autosomes (i.e., the human chromosomes 1-22) in which a trait manifests in heterozygotes. In the context of medical genetics, an autosomal dominant disorder is caused when a single copy of the mutant allele is present. Males and females are affected equally, and can both transmit the disorder with a risk of 50% for each child of inheriting the mutant allele. Evidence: TAS. (OMIM:176700)
These phenotypes are associated with the disease autosomal dominant prognathism (OMIM:176700).